- Abnormal blistering of the skin (HP:0008066): The presence of one or more bullae on the skin, defined as fluid-filled blisters more than 5 mm in diameter with thin walls. Evidence: TAS. (OMIM:113800)
- Scaling skin (HP:0040189): Refers to the loss of the outer layer of the epidermis in large, scale-like flakes. Evidence: TAS. (OMIM:113800)
- Congenital bullous ichthyosiform erythroderma (HP:0007475): An ichthyosiform abnormality of the skin that presents at birth or shortly thereafter with generalized erythema, blistering, erosions, and peeling. In the subsequent months, erythema and blistering improves but patients go on to develop hyperkeratotic scaling that is especially prominent along the joint flexures, neck, hands and feet. Evidence: TAS. (OMIM:113800)
- Epidermal acanthosis (HP:0025092): Diffuse hypertrophy or thickening of the stratum spinosum of the epidermis (prickle cell layer of the skin). Evidence: TAS. (OMIM:113800)
- Erythroderma (HP:0001019): An inflammatory exfoliative dermatosis involving nearly all of the surface of the skin. Erythroderma develops suddenly. A patchy erythema may generalize and spread to affect most of the skin. Scaling may appear in 2-6 days and be accompanied by hot, red, dry skin, malaise, and fever. Evidence: TAS. (OMIM:113800)
- Autosomal recessive inheritance (HP:0000007): A mode of inheritance that is observed for traits related to a gene encoded on one of the autosomes (i.e., the human chromosomes 1-22) in which a trait manifests in individuals with two pathogenic alleles, either homozygotes (two copies of the same mutant allele) or compound heterozygotes (whereby each copy of a gene has a distinct mutant allele). Evidence: TAS. (OMIM:113800)
- Palmoplantar hyperkeratosis (HP:0000972): Abnormal thickening of the skin localized to the palm of the hand and the sole of the foot. Evidence: TAS. (OMIM:113800)
- Autosomal dominant inheritance (HP:0000006): A mode of inheritance that is observed for traits related to a gene encoded on one of the autosomes (i.e., the human chromosomes 1-22) in which a trait manifests in heterozygotes. In the context of medical genetics, an autosomal dominant disorder is caused when a single copy of the mutant allele is present. Males and females are affected equally, and can both transmit the disorder with a risk of 50% for each child of inheriting the mutant allele. Evidence: IEA. (OMIM:113800)
These phenotypes are associated with the disease epidermolytic hyperkeratosis 1 (OMIM:113800).